Phenotypes associated with the disease precocious puberty, central, 2 (OMIM:615346):
- Autosomal dominant inheritance with maternal imprinting (HP:0012275): A type of autosomal dominant inheritance involving a gene that is imprinted with maternal silencing. Evidence: PCS. (PMID:26431553)
- Accelerated skeletal maturation (HP:0005616): An abnormally increased rate of skeletal maturation. Accelerated skeletal maturation can be diagnosed on the basis of an estimation of the bone age from radiographs of specific bones in the human body. Evidence: PCS. (PMID:23738509)
- Premature pubarche (HP:0012411): The onset of growth of pubic hair at an earlier age than normal. Evidence: PCS. (PMID:23738509)
- Premature thelarche (HP:0010314): Premature development of the breasts. Evidence: PCS. (PMID:26431553)